- Hearing impairment (HP:0000365): A decreased magnitude of the sensory perception of sound. Evidence: TAS. Frequency: Very frequent (HP:0040281). (ORPHA:1508)
- Atresia of the external auditory canal (HP:0000413): Absence or failure to form of the external auditory canal. Evidence: TAS. Frequency: Very frequent (HP:0040281). (ORPHA:1508)
- Abnormal pelvic girdle bone morphology (HP:0002644): An abnormality of the bony pelvic girdle, which is a ring of bones connecting the vertebral column to the femurs. Evidence: TAS. Frequency: Very frequent (HP:0040281). (ORPHA:1508)
- Abnormal femur morphology (HP:0002823): Any anomaly of the structure of the femur. Evidence: TAS. Frequency: Very frequent (HP:0040281). (ORPHA:1508)
- Hip dislocation (HP:0002827): Displacement of the femur from its normal location in the hip joint. Evidence: TAS. Frequency: Very frequent (HP:0040281). (ORPHA:1508)
- Micromelia (HP:0002983): The presence of abnormally small extremities. Evidence: TAS. Frequency: Very frequent (HP:0040281). (ORPHA:1508)
- Short stature (HP:0004322): A height below that which is expected according to age and gender norms. Although there is no universally accepted definition of short stature, many refer to "short stature" as height more than 2 standard deviations below the mean for age and gender (or below the 3rd percentile for age and gender dependent norms). Evidence: TAS. Frequency: Very frequent (HP:0040281). (ORPHA:1508)
- Reduced bone mineral density (HP:0004349): A reduction of bone mineral density, that is, of the amount of matter per cubic centimeter of bones. Evidence: TAS. Frequency: Very frequent (HP:0040281). (ORPHA:1508)
- Microtia (HP:0008551): Underdevelopment of the external ear. Evidence: TAS. Frequency: Very frequent (HP:0040281). (ORPHA:1508)
These phenotypes are associated with the disease Coxoauricular syndrome (ORPHA:1508).